Phenotypes associated with the disease epilepsy, idiopathic generalized, susceptibility to, 7 (OMIM:604827, an entry in Online Mendelian Inheritance in Man):
- Bilateral tonic-clonic seizure (HP:0002069, a Human Phenotype Ontology term): A bilateral tonic-clonic seizure is a seizure defined by a tonic (bilateral increased tone, lasting seconds to minutes) and then a clonic (bilateral sustained rhythmic jerking) phase. Evidence: TAS. (OMIM:604827)
- Autosomal recessive inheritance (HP:0000007, a Human Phenotype Ontology term): A mode of inheritance that is observed for traits related to a gene encoded on one of the autosomes (i.e., the human chromosomes 1-22) in which a trait manifests in individuals with two pathogenic alleles, either homozygotes (two copies of the same mutant allele) or compound heterozygotes (whereby each copy of a gene has a distinct mutant allele). Evidence: IEA. (OMIM:604827)
- Myoclonus (HP:0001336, a Human Phenotype Ontology term): Very brief, involuntary random muscular contractions occurring at rest, in response to sensory stimuli, or accompanying voluntary movements. Evidence: TAS. (OMIM:604827)